Phenotypes associated with the disease dyslexia, susceptibility to, 1 (OMIM:127700):
- Abnormal speech pattern (HP:0002167): An abnormality in the sound (volume) or cadence (rate) of speech. Evidence: TAS. (OMIM:127700)
- Dyslexia (HP:0010522): A learning disorder characterized primarily by difficulties in learning to read and spell. Dyslectic children also exhibit a tendency to read words from right to left and to confuse letters such as b and d whose orientation is important for their identification. Children with dyslexia appear to be impaired in phonemic skills (the ability to associate visual symbols with the sounds they represent). Evidence: TAS. (OMIM:127700)
- Autosomal dominant inheritance (HP:0000006): A mode of inheritance that is observed for traits related to a gene encoded on one of the autosomes (i.e., the human chromosomes 1-22) in which a trait manifests in heterozygotes. In the context of medical genetics, an autosomal dominant disorder is caused when a single copy of the mutant allele is present. Males and females are affected equally, and can both transmit the disorder with a risk of 50% for each child of inheriting the mutant allele. Evidence: TAS. (OMIM:127700)